Phenotypes associated with the disease factor 5 excess with spontaneous thrombosis (OMIM:134400):
- Peripheral arterial stenosis (HP:0004950): Narrowing of peripheral arteries with reduction of blood flow to the limbs. This feature may be quantified as an ankle-brachial index of less than 0.9, and may be manifested clinically as claudication. Evidence: TAS. (OMIM:134400)
- Recurrent thrombophlebitis (HP:0004419): Repeated episodes of inflammation of a vein associated with venous thrombosis (blood clot formation within the vein). Evidence: TAS. (OMIM:134400)
- Autosomal dominant inheritance (HP:0000006): A mode of inheritance that is observed for traits related to a gene encoded on one of the autosomes (i.e., the human chromosomes 1-22) in which a trait manifests in heterozygotes. In the context of medical genetics, an autosomal dominant disorder is caused when a single copy of the mutant allele is present. Males and females are affected equally, and can both transmit the disorder with a risk of 50% for each child of inheriting the mutant allele. Evidence: TAS. (OMIM:134400)
- Pulmonary embolism (HP:0002204): An embolus (that is, an abnormal particle circulating in the blood) located in the pulmonary artery and thereby blocking blood circulation to the lung. Usually the embolus is a blood clot that has developed in an extremity (for instance, a deep venous thrombosis), detached, and traveled through the circulation before becoming trapped in the pulmonary artery. Evidence: TAS. (OMIM:134400)
- Elevated coagulation factor V activity (HP:0011996): Increased activity of coagulation factor V, Factor V, which is activated to factor Va by means of minute amounts of thrombin (and inactivated by larger amounts of thrombin). Activated factor V (fVa) is a cofactor in the formation of the prothrombinase complex. Evidence: TAS. (OMIM:134400)